Phenotypes associated with the disease DERMATOGLYPHICS--ARCH ON ANY DIGIT (OMIM:125570):
- Abnormal palmar dermal ridges (HP:0007608). Evidence: TAS. (OMIM:125570)
- Autosomal dominant inheritance (HP:0000006): A mode of inheritance that is observed for traits related to a gene encoded on one of the autosomes (i.e., the human chromosomes 1-22) in which a trait manifests in heterozygotes. In the context of medical genetics, an autosomal dominant disorder is caused when a single copy of the mutant allele is present. Males and females are affected equally, and can both transmit the disorder with a risk of 50% for each child of inheriting the mutant allele. Evidence: TAS. (OMIM:125570)